- Abnormality of the face (HP:0000271): An abnormality of the face. Evidence: TAS. Frequency: Very frequent (HP:0040281). (ORPHA:398147)
- Chronic pain (HP:0012532): Persistent pain, usually defined as pain that has lasted longer than 3 to 6 months. Evidence: TAS. Frequency: Very frequent (HP:0040281). (ORPHA:398147)
- Dull (HP:0025282): Applied to pain that is dull, i.e., not severe but that continues over a long period of time. Evidence: TAS. Frequency: Frequent (HP:0040282). (ORPHA:398147)
- Depression (HP:0000716): Frequently experiencing feelings of being down, miserable, and/or hopeless; struggling to recover from these moods; having a pessimistic outlook on the future; feeling a pervasive sense of shame; having a low self-worth; experiencing thoughts of suicide and engaging in suicidal behavior. Evidence: TAS. Frequency: Occasional (HP:0040283). (ORPHA:398147)
- Anxiety (HP:0000739): Intense feelings of nervousness, tension, or panic often arise in response to interpersonal stresses. There is worry about the negative effects of past unpleasant experiences and future negative possibilities. Individuals may feel fearful, apprehensive, or threatened by uncertainty, and they may also have fears of falling apart or losing control. Evidence: TAS. Frequency: Occasional (HP:0040283). (ORPHA:398147)
- Paresthesia (HP:0003401): Abnormal sensations such as tingling, pricking, or numbness of the skin with no apparent physical cause. Evidence: TAS. Frequency: Occasional (HP:0040283). (ORPHA:398147)
- Acute episodes of neuropathic symptoms (HP:0003489). Evidence: TAS. Frequency: Occasional (HP:0040283). (ORPHA:398147)
- Impaired pain sensation (HP:0007328): Reduced ability to perceive painful stimuli. Evidence: TAS. Frequency: Occasional (HP:0040283). (ORPHA:398147)
- Burning mouth (HP:0032143): An intense sensation of burning, scalding, or tingling feeling of the tongue or other regions of the oral mucosa. Evidence: TAS. Frequency: Occasional (HP:0040283). (ORPHA:398147)
- Somatic sensory dysfunction (HP:0003474): An abnormality of the primary sensation that is mediated by peripheral nerves (pain, temperature, touch, vibration, joint position). The word hypoesthesia (or hypesthesia) refers to a reduction in cutaneous sensation to a specific type of testing. Evidence: TAS. Frequency: Very rare (HP:0040284). (ORPHA:398147)
These phenotypes are associated with the disease Persistent idiopathic facial pain (ORPHA:398147).
The following phenotypes are NOT associated with this disease:
- Abnormal nervous system morphology (HP:0012639): A structural anomaly of the nervous system. Evidence: TAS. (ORPHA:398147)